- Epicanthus (HP:0000286): A fold of skin starting above the medial aspect of the upper eyelid and arching downward to cover, pass in front of and lateral to the medial canthus. Evidence: PCS. Frequency: 1/6. (PMID:15150541)
- Opacification of the corneal stroma (HP:0007759): Reduced transparency of the stroma of cornea. Evidence: IEA. (OMIM:612582)
- Tented upper lip vermilion (HP:0010804): Triangular appearance of the oral aperture with the apex in the midpoint of the upper vermilion and the lower vermilion forming the base. Evidence: TAS. (OMIM:612582)
- Anal atresia (HP:0002023): Congenital absence of the anus, i.e., the opening at the bottom end of the intestinal tract. Evidence: PCS. Frequency: 1/6. (PMID:15150541)
- Strabismus (HP:0000486): A misalignment of the eyes so that the visual axes deviate from bifoveal fixation. The classification of strabismus may be based on a number of features including the relative position of the eyes, whether the deviation is latent or manifest, intermittent or constant, concomitant or otherwise and according to the age of onset and the relevance of any associated refractive error. Evidence: PCS. Frequency: 3/6. (PMID:15150541)
- Axenfeld anomaly (HP:0001492): Axenfeld's anomaly is a bilateral disorder characterized by a prominent, anteriorly displaced Schwalbe's line (posterior embryotoxon) and peripheral iris strands which span the anterior chamber angle to attach to Schwalbe's line. Evidence: IEA. (OMIM:612582)
- Seizure (HP:0001250): A seizure is an intermittent abnormality of nervous system physiology characterized by a transient occurrence of signs and/or symptoms due to abnormal excessive or synchronous neuronal activity in the brain. Evidence: PCS. Frequency: 1/6. (PMID:15150541)
- Narrow mouth (HP:0000160): Distance between the commissures of the mouth more than 2 SD below the mean. Alternatively, an apparently decreased width of the oral aperture (subjective). Evidence: PCS. Frequency: 1/6. (PMID:15150541)
- Hypotonia (HP:0001252): Hypotonia is an abnormally low muscle tone (the amount of tension or resistance to movement in a muscle). Even when relaxed, muscles have a continuous and passive partial contraction which provides some resistance to passive stretching. Hypotonia thus manifests as diminished resistance to passive stretching. Hypotonia is not the same as muscle weakness, although the two conditions can co-exist. Evidence: IEA. (OMIM:612582)
- Skin tags (HP:0010609): Cutaneous skin tags also known as acrochorda or fibroepithelial polyps are small benign tumors that may either form secondarily over time primarily in areas where the skin forms creases, such as the neck, armpit or groin or may also be present at birth, in which case they usually occur in the periauricular region. Evidence: PCS. Frequency: 1/6. (PMID:15150541)
- Infantile onset (HP:0003593): Onset of signs or symptoms of disease between 28 days to one year of life. Evidence: PCS. Frequency: 1/6. (PMID:15150541)
- Generalized hypotonia (HP:0001290): Generalized muscular hypotonia (abnormally low muscle tone). Evidence: TAS. (OMIM:612582)
- Short palpebral fissure (HP:0012745): Distance between the medial and lateral canthi is more than 2 SD below the mean for age (objective); or, apparently reduced length of the palpebral fissures. Evidence: PCS. Frequency: 1/6. (PMID:15150541)
- Hypertelorism (HP:0000316): Interpupillary distance more than 2 SD above the mean (alternatively, the appearance of an increased interpupillary distance or widely spaced eyes). Evidence: PCS. Frequency: 5/6. (PMID:15150541)
- Specific learning disability (HP:0001328): Impairment of certain skills such as reading or writing, coordination, self-control, or attention that interfere with the ability to learn. The impairment is not related to a global deficiency of intelligence. Evidence: IEA. (OMIM:612582)
- Telangiectasia (HP:0001009): Telangiectasias refer to small dilated blood vessels located near the surface of the skin or mucous membranes, measuring between 0.5 and 1 millimeter in diameter. Telangiectasia are located especially on the tongue, lips, palate, fingers, face, conjunctiva, trunk, nail beds, and fingertips. Evidence: PCS. Frequency: 1/6. (PMID:15150541)
- Dental crowding (HP:0000678): Changes in alignment of teeth in the dental arch. Evidence: IEA. (OMIM:612582)
- Hydrocephalus (HP:0000238): Hydrocephalus is an active distension of the ventricular system of the brain resulting from inadequate passage of CSF from its point of production within the cerebral ventricles to its point of absorption into the systemic circulation. Evidence: PCS. Frequency: 1/6. (PMID:15150541)
- Patent ductus arteriosus (HP:0001643): In utero, the ductus arteriosus (DA) serves to divert ventricular output away from the lungs and toward the placenta by connecting the main pulmonary artery to the descending aorta. A patent ductus arteriosus (PDA) in the first 3 days of life is a physiologic shunt in healthy term and preterm newborn infants, and normally is substantially closed within about 24 hours after bith and completely closed after about three weeks. Failure of physiologcal closure is referred to a persistent or patent ductus arteriosus (PDA). Depending on the degree of left-to-right shunting, PDA can have clinical consequences. Evidence: PCS. Frequency: 2/6. (PMID:15150541)
- Sporadic (HP:0003745): Cases of the disease in question occur without a previous family history, i.e., as isolated cases without being transmitted from a parent and without other siblings being affected. Evidence: PCS. (PMID:15150541)
- Short 2nd toe (HP:0001885): Underdevelopment (hypoplasia) of the second toe. Evidence: PCS. Frequency: 1/6. (PMID:15150541)
- Intellectual disability (HP:0001249): The term intellectual disability or intellectual developmental disorder is used to describe significantly sub-average intellectual and adaptive functioning based on clinical assessment and as measured by individually administered, appropriately normed, standardized and validated tests of intellectual functioning and adaptive behavior, with onset during the developmental period from infancy through adolescence. Evidence: TAS. (OMIM:612582)
- Posteriorly rotated ears (HP:0000358): A type of abnormal location of the ears in which the position of the ears is characterized by posterior rotation (the superior part of the ears is rotated towards the back of the head, and the inferior part of the ears towards the front). Evidence: PCS. Frequency: 3/6. (PMID:15150541)
- Downslanted palpebral fissures (HP:0000494): The palpebral fissure inclination is more than two standard deviations below the mean. Evidence: PCS. Frequency: 1/6. (PMID:15150541)
- Hip dysplasia (HP:0001385): The presence of developmental dysplasia of the hip. Evidence: IEA. (OMIM:612582)
- Joint hypermobility (HP:0001382): The capability that a joint (or a group of joints) has to move, passively and/or actively, beyond normal limits along physiological axes. Evidence: PCS. Frequency: 1/6. (PMID:15150541)
- Global developmental delay (HP:0001263): A delay in the achievement of motor or mental milestones in the domains of development of a child, including motor skills, speech and language, cognitive skills, and social and emotional skills. This term should only be used to describe children younger than five years of age. Evidence: PCS. Frequency: 5/6. (PMID:15150541)
- Midface retrusion (HP:0011800): Posterior positions and/or vertical shortening of the infraorbital and perialar regions, or increased concavity of the face and/or reduced nasolabial angle. Evidence: TAS. (OMIM:612582)
- Sensorineural hearing impairment (HP:0000407): A type of hearing impairment in one or both ears related to an abnormal functionality of the cochlear nerve. Evidence: PCS. Frequency: 3/6. (PMID:15150541)
- Underdeveloped supraorbital ridges (HP:0009891): Flatness of the supraorbital portion of the frontal bones. Evidence: PCS. Frequency: 1/6. (PMID:15150541)
- Pectus excavatum (HP:0000767): A defect of the chest wall characterized by a depression of the sternum, giving the chest ("pectus") a caved-in ("excavatum") appearance. Evidence: PCS. Frequency: 2/6. (PMID:15150541)
- Umbilical hernia (HP:0001537): Protrusion of abdominal contents through a defect in the abdominal wall musculature around the umbilicus. Skin and subcutaneous tissue overlie the defect. Evidence: PCS. Frequency: 1/6. (PMID:15150541)
- Clinodactyly of the 5th finger (HP:0004209): Clinodactyly refers to a bending or curvature of the fifth finger in the radial direction (i.e., towards the 4th finger). Evidence: PCS. Frequency: 1/6. (PMID:15150541)
- Brachycephaly (HP:0000248): An abnormality of skull shape characterized by a decreased anterior-posterior diameter. That is, a cephalic index greater than 81%. Alternatively, an apparently shortened anteroposterior dimension (length) of the head compared to width. Evidence: PCS. Frequency: 1/6. (PMID:15150541)
- Cleft upper lip (HP:0000204): A gap or groove in the upper lip. This is a congenital defect resulting from nonfusion of tissues of the lip during embryonal development. Evidence: PCS. Frequency: 1/6. (PMID:15150541)
- Low-set ears (HP:0000369): Upper insertion of the ear to the scalp below an imaginary horizontal line drawn between the inner canthi of the eye and extending posteriorly to the ear. Evidence: PCS. Frequency: 3/6. (PMID:15150541)
- Patent foramen ovale (HP:0001655): Failure of the foramen ovale to seal postnatally, leaving a potential conduit between the left and right cardiac atria. Evidence: PCS. Frequency: 2/6. (PMID:15150541)
- Congenital onset (HP:0003577): A phenotypic abnormality that is present at birth. Evidence: PCS. Frequency: 5/6. (PMID:15150541)
- Preauricular pit (HP:0004467): Small indentation anterior to the insertion of the ear. Evidence: PCS. Frequency: 1/6. (PMID:15150541)
- Hypermetropia (HP:0000540): An abnormality of refraction characterized by the ability to see objects in the distance clearly, while objects nearby appear blurry. Evidence: IEA. (OMIM:612582)
- Agenesis of corpus callosum (HP:0001274): Absence of the corpus callosum as a result of the failure of the corpus callosum to develop, which can be the result of a failure in any one of the multiple steps of callosal development including cellular proliferation and migration, axonal growth or glial patterning at the midline. Evidence: PCS. Frequency: 1/6. (PMID:15150541)
- Pigmentary retinopathy (HP:0000580): An abnormality of the retina characterized by pigment deposition. It is typically associated with migration and proliferation of macrophages or retinal pigment epithelial cells into the retina; melanin from these cells causes the pigmentary changes. Pigmentary retinopathy is a common final pathway of many retinal conditions and is often associated with visual loss. Evidence: PCS. Frequency: 1/6. (PMID:15150541)
- Motor delay (HP:0001270): A type of Developmental delay characterized by a delay in acquiring motor skills. Evidence: PCS. Frequency: 4/6. (PMID:15150541)
- Ventricular septal defect (HP:0001629): A hole between the two bottom chambers (ventricles) of the heart. The defect is centered around the most superior aspect of the ventricular septum. Evidence: PCS. Frequency: 1/6. (PMID:15150541)
- Chronic constipation (HP:0012450): Constipation for longer than three months with fewer than 3 bowel movements per week, straining, lumpy or hard stools, and a sensation of anorectal obstruction or incomplete defecation. Evidence: PCS. Frequency: 1/6. (PMID:15150541)
- Broad forehead (HP:0000337): Width of the forehead or distance between the frontotemporales is more than two standard deviations above the mean (objective); or apparently increased distance between the two sides of the forehead. Evidence: IEA. (OMIM:612582)
- Dandy-Walker malformation (HP:0001305): A congenital brain malformation typically characterized by incomplete formation of the cerebellar vermis, dilation of the fourth ventricle, and enlargement of the posterior fossa. In layman's terms, Dandy Walker malformation is a cyst in the cerebellum (typically symmetrical) that is involved with the fourth ventricle. This may interfere with the ability to drain cerebrospinal fluid from the brain, resulting in hydrocephalus. Dandy Walker cysts are formed during early embryonic development, while the brain forms. The cyst in the cerebellum typically has several blood vessels running through it connecting to the brain, thereby prohibiting surgical removal. Evidence: IEA. (OMIM:612582)
- Peters anomaly (HP:0000659): A form of anterior segment dysgenesis in which abnormal cleavage of the anterior chamber occurs. Peters anomaly is characterized by central, paracentral, or complete corneal opacity. Evidence: PCS. Frequency: 1/6. (PMID:15150541)
- High palate (HP:0000218): Height of the palate more than 2 SD above the mean (objective) or palatal height at the level of the first permanent molar more than twice the height of the teeth (subjective). Evidence: PCS. Frequency: 1/6. (PMID:15150541)
- Macrocephaly (HP:0000256): Occipitofrontal (head) circumference greater than 97th centile compared to appropriate, age matched, sex-matched normal standards. Alternatively, a apparently increased size of the cranium. Evidence: PCS. Frequency: 1/6. (PMID:15150541)
- Ocular anterior segment dysgenesis (HP:0007700): Abnormal development (dysgenesis) of the anterior segment of the eye globe. These structures are mainly of mesenchymal origin. Evidence: PCS. Frequency: 1/6. (PMID:15150541)
- Frontal upsweep of hair (HP:0002236): Upward and/or sideward growth of anterior hair. Evidence: PCS. Frequency: 1/6. (PMID:15150541)
- Exotropia (HP:0000577): A form of strabismus with one or both eyes deviated outward. Evidence: IEA. (OMIM:612582)
- Delayed speech and language development (HP:0000750): A degree of language development that is significantly below the norm for a child of a specified age. Evidence: PCS. Frequency: 12/16. (OMIM:612582;PMID:15150541)
- Blue sclerae (HP:0000592): An abnormal bluish coloration of the sclera. Evidence: PCS. Frequency: 1/6. (PMID:15150541)
- Malar flattening (HP:0000272): Underdevelopment of the malar prominence of the jugal bone (zygomatic bone in mammals), appreciated in profile, frontal view, and/or by palpation. Evidence: IEA. (OMIM:612582)
- Short neck (HP:0000470): Diminished length of the neck. Evidence: PCS. Frequency: 1/6. (PMID:15150541)
- Depressed nasal bridge (HP:0005280): Posterior positioning of the nasal root in relation to the overall facial profile for age. Evidence: IEA. (OMIM:612582)
- Rocker bottom foot (HP:0001838): The presence of both a prominent heel and a convex contour of the sole. Evidence: IEA. (OMIM:612582)
- Abnormal dental morphology (HP:0006482): An abnormality of the morphology of the tooth. Evidence: IEA. (OMIM:612582)
- Posterior embryotoxon (HP:0000627): A posterior embryotoxon is the presence of a prominent and anteriorly displaced line of Schwalbe. Evidence: PCS. Frequency: 1/6. (PMID:15150541)
- Telecanthus (HP:0000506): Distance between the inner canthi more than two standard deviations above the mean (objective); or, apparently increased distance between the inner canthi. Evidence: PCS. Frequency: 1/6. (PMID:15150541)
- Broad toe (HP:0001837): Visible increase in width of the non-hallux digit without an increase in the dorso-ventral dimension. Evidence: PCS. Frequency: 1/6. (PMID:15150541)
- Tetralogy of Fallot (HP:0001636): A congenital cardiac malformation comprising pulmonary stenosis, overriding aorta, ventricular septum defect, and right ventricular hypertrophy. The diagnosis of TOF is made if at least three of the four above mentioned features are present. Evidence: IEA. (OMIM:612582)
- Frontal bossing (HP:0002007): Bilateral bulging of the lateral frontal bone prominences with relative sparing of the midline. Evidence: TAS. (OMIM:612582)
- Atrial septal defect (HP:0001631): Atrial septal defect (ASD) is a congenital abnormality of the interatrial septum that enables blood flow between the left and right atria via the interatrial septum. Evidence: PCS. Frequency: 1/6. (PMID:15150541)
These phenotypes are associated with the disease chromosome 6pter-p24 deletion syndrome (OMIM:612582).